Phenotypes associated with the disease epilepsy, progressive myoclonic, 11 (OMIM:618876):
- Cerebellar vermis hypoplasia (HP:0001320): Underdevelopment of the vermis of cerebellum. Evidence: PCS. Frequency: 1/4. (PMID:32169168)
- Typically de novo (HP:0025352): Description of conditions that are exclusively or predominantly observed to display de novo variants. In some cases, this may be due to the limited reproductive fitness of affected individuals. Evidence: PCS. (PMID:32169168)
- Delayed speech and language development (HP:0000750): A degree of language development that is significantly below the norm for a child of a specified age. Evidence: PCS. Frequency: 4/4. (PMID:32169168)
- Developmental regression (HP:0002376): Loss of developmental skills, as manifested by loss of developmental milestones. Evidence: PCS. Onset: Childhood onset (HP:0011463). (PMID:32169168)
- Delayed ability to walk (HP:0031936): A failure to achieve the ability to walk at an appropriate developmental stage. Most children learn to walk in a series of stages, and learn to walk short distances independently between 12 and 15 months. Evidence: PCS. Frequency: 3/4. Onset: Infantile onset (HP:0003593). (PMID:32169168)
- Seizure (HP:0001250): A seizure is an intermittent abnormality of nervous system physiology characterized by a transient occurrence of signs and/or symptoms due to abnormal excessive or synchronous neuronal activity in the brain. Evidence: IEA. Frequency: 4/4. (PMID:32169168)
- Cerebellar atrophy (HP:0001272): Cerebellar atrophy is defined as a cerebellum with initially normal structures, in a posterior fossa with normal size, which displays enlarged fissures (interfolial spaces) in comparison to the foliae secondary to loss of tissue. Cerebellar atrophy implies irreversible loss of tissue and result from an ongoing progressive disease until a final stage is reached or a single injury, e.g. an intoxication or infectious event. Evidence: PCS. Frequency: 1/4. (PMID:32169168)
- Global developmental delay (HP:0001263): A delay in the achievement of motor or mental milestones in the domains of development of a child, including motor skills, speech and language, cognitive skills, and social and emotional skills. This term should only be used to describe children younger than five years of age. Evidence: PCS. Frequency: 4/4. (PMID:32169168)
- Rigidity (HP:0002063): Continuous involuntary sustained muscle contraction. When an affected muscle is passively stretched, the degree of resistance remains constant regardless of the rate at which the muscle is stretched. This feature helps to distinguish rigidity from muscle spasticity. Evidence: PCS. Frequency: 2/2. (PMID:32169168)
- Ataxia (HP:0001251): Ataxia refers to impaired coordination of voluntary muscle movement. Cerebellar ataxia refers to ataxia due to dysfunction of the cerebellum. This causes a variety of elementary neurological deficits including asynergy (lack of coordination between muscles, limbs and joints), dysmetria (lack of ability to judge distances that can lead to under- or overshoot in grasping movements), and dysdiadochokinesia (inability to perform rapid movements requiring antagonizing muscle groups to be switched on and off repeatedly). Evidence: PCS. Frequency: 4/4. (PMID:32169168)
- Intention tremor (HP:0002080): A type of kinetic tremor that occurs during target directed movement is called intention tremor. That is, an oscillatory cerebellar ataxia that tends to be absent when the limbs are inactive and during the first part of voluntary movement but worsening as the movement continues and greater precision is required (e.g., in touching a target such as the patient's nose or a physician's finger). Evidence: PCS. Frequency: 4/4. (PMID:32169168)
- Severe intellectual disability (HP:0010864): Severe intellectual disability (ID) is defined as a type of ID characterized by severely sub-average adaptive functioning and intellectual functioning, with an intelligence quotient (IQ) the range of 20-34. Evidence: PCS. Frequency: 4/4. (PMID:32169168)
- Systemic lupus erythematosus (HP:0002725): A chronic, relapsing, inflammatory, and often febrile multisystemic disorder of connective tissue, characterized principally by involvement of the skin, joints, kidneys, and serosal membranes. Evidence: PCS. Frequency: 1/4. (PMID:32169168)
- Giant somatosensory evoked potentials (HP:0001312): An abnormal enlargement (i.e. increase in measured voltage) of somatosensory evoked potentials. Evidence: PCS. Frequency: 1/4. (PMID:32169168)
- Autosomal dominant inheritance (HP:0000006): A mode of inheritance that is observed for traits related to a gene encoded on one of the autosomes (i.e., the human chromosomes 1-22) in which a trait manifests in heterozygotes. In the context of medical genetics, an autosomal dominant disorder is caused when a single copy of the mutant allele is present. Males and females are affected equally, and can both transmit the disorder with a risk of 50% for each child of inheriting the mutant allele. Evidence: PCS. (PMID:32169168)
- Myoclonus (HP:0001336): Very brief, involuntary random muscular contractions occurring at rest, in response to sensory stimuli, or accompanying voluntary movements. Evidence: PCS. Frequency: 3/3. (PMID:32169168)
- Hyperreflexia (HP:0001347): Hyperreflexia is the presence of hyperactive stretch reflexes of the muscles. Evidence: PCS. Frequency: 2/3. (PMID:32169168)